- Autosomal recessive inheritance (HP:0000007): A mode of inheritance that is observed for traits related to a gene encoded on one of the autosomes (i.e., the human chromosomes 1-22) in which a trait manifests in individuals with two pathogenic alleles, either homozygotes (two copies of the same mutant allele) or compound heterozygotes (whereby each copy of a gene has a distinct mutant allele). Evidence: TAS. (OMIM:612460)
- Obesity (HP:0001513): Accumulation of substantial excess body fat. Evidence: TAS. (OMIM:612460)
These phenotypes are associated with the disease Obesity, susceptibility to, BMIQ14 (OMIM:612460).